- Bilateral tonic-clonic seizure (HP:0002069): A bilateral tonic-clonic seizure is a seizure defined by a tonic (bilateral increased tone, lasting seconds to minutes) and then a clonic (bilateral sustained rhythmic jerking) phase. Evidence: PCS. Frequency: 6/9. (PMID:24928908)
- Juvenile onset (HP:0003621): Onset of signs or symptoms of disease between the age of 5 and 15 years. Evidence: PCS. Frequency: 3/7. (PMID:24928908)
- Intermediate young adult onset (HP:0025709): Onset of disease at an age of greater than or equal to 19 to under 25 years. Evidence: PCS. Frequency: 2/7. (PMID:24928908)
- Generalized myoclonic seizure (HP:0002123): A generalized myoclonic seizure is a type of generalized motor seizure characterized by bilateral, sudden, brief (<100 ms) involuntary single or multiple contraction of muscles or muscle groups of variable topography (axial, proximal limb, distal). Myoclonus is less regularly repetitive and less sustained than is clonus. Evidence: PCS. Frequency: 3/9. (PMID:24928908)
- Febrile seizure (within the age range of 3 months to 6 years) (HP:0002373): A febrile seizure is any type of seizure (most often a generalized tonic-clonic seizure) occurring with fever (at least 38 degrees Celsius) but in the absence of central nervous system infection, severe metabolic disturbance or other alternative precipitant in children between the ages of 3 months and 6 years. Evidence: PCS. Frequency: 0/8. (PMID:24928908)
- Seizure (HP:0001250): A seizure is an intermittent abnormality of nervous system physiology characterized by a transient occurrence of signs and/or symptoms due to abnormal excessive or synchronous neuronal activity in the brain. Evidence: PCS. Frequency: 9/9. (PMID:24928908)
- Generalized non-motor (absence) seizure (HP:0002121): A generalized non-motor (absence) seizure is a type of a type of dialeptic seizure that is of electrographically generalized onset. It is a generalized seizure characterized by an interruption of activities, a blank stare, and usually the person will be unresponsive when spoken to. Any ictal motor phenomena are minor in comparison to these non-motor features. Evidence: PCS. Frequency: 4/9. (PMID:24928908)
- Childhood onset (HP:0011463): Onset of disease at the age of between 1 and 5 years. Evidence: PCS. Frequency: 1/7. (PMID:24928908)
- Typified by incomplete penetrance (HP:0003829): Description of conditions in which not all individuals with a given genotype exhibit the disease. Penetrance is the proportion that develop disease given a lifespan of 80 years. Evidence: TAS. (OMIM:616685)
- Autosomal dominant inheritance (HP:0000006): A mode of inheritance that is observed for traits related to a gene encoded on one of the autosomes (i.e., the human chromosomes 1-22) in which a trait manifests in heterozygotes. In the context of medical genetics, an autosomal dominant disorder is caused when a single copy of the mutant allele is present. Males and females are affected equally, and can both transmit the disorder with a risk of 50% for each child of inheriting the mutant allele. Evidence: PCS. (PMID:24928908)
These phenotypes are associated with the disease epilepsy, idiopathic generalized, susceptibility to, 14 (OMIM:616685).